Phenotypes associated with the disease attention deficit-hyperactivity disorder, susceptibility to, 7 (OMIM:613003):
- Depression (HP:0000716): Frequently experiencing feelings of being down, miserable, and/or hopeless; struggling to recover from these moods; having a pessimistic outlook on the future; feeling a pervasive sense of shame; having a low self-worth; experiencing thoughts of suicide and engaging in suicidal behavior. Evidence: PCS. Frequency: 1/2. (PMID:18347598)
- Global developmental delay (HP:0001263): A delay in the achievement of motor or mental milestones in the domains of development of a child, including motor skills, speech and language, cognitive skills, and social and emotional skills. This term should only be used to describe children younger than five years of age. Evidence: PCS. Frequency: 0/2. (PMID:18347598)
- Attention deficit hyperactivity disorder (HP:0007018): Attention deficit hyperactivity disorder (ADHD) manifests at age 2-3 years or by first grade at the latest. The main symptoms are distractibility, impulsivity, hyperactivity, and often trouble organizing tasks and projects, difficulty going to sleep, and social problems from being aggressive, loud, or impatient. Evidence: PCS. Frequency: 2/2. (PMID:18347598)
- Autosomal dominant inheritance (HP:0000006): A mode of inheritance that is observed for traits related to a gene encoded on one of the autosomes (i.e., the human chromosomes 1-22) in which a trait manifests in heterozygotes. In the context of medical genetics, an autosomal dominant disorder is caused when a single copy of the mutant allele is present. Males and females are affected equally, and can both transmit the disorder with a risk of 50% for each child of inheriting the mutant allele. Evidence: PCS. (PMID:18347598)